- Premature birth (HP:0001622): The birth of a baby of less than 37 weeks of gestational age. Evidence: TAS. Frequency: Very frequent (HP:0040281). (ORPHA:1118)
- Split hand (HP:0001171): A condition in which middle parts of the hand (fingers and metacarpals) are missing giving a cleft appearance. The severity is very variable ranging from slightly hypoplastic middle fingers over absent middle fingers as far as oligo- or monodactyl hands. Evidence: TAS. Frequency: Frequent (HP:0040282). (ORPHA:1118)
- Aplasia/Hypoplasia of the fibula (HP:0006492): Absence or underdevelopment of the fibula. Evidence: TAS. Frequency: Frequent (HP:0040282). (ORPHA:1118)
- Abnormal morphology of ulna (HP:0040071): Any structural anomaly of the ulna, a bone of the forearm the extends from the elbow to the little finger. Evidence: TAS. Frequency: Frequent (HP:0040282). (ORPHA:1118)
These phenotypes are associated with the disease Fibular aplasia-ectrodactyly syndrome (ORPHA:1118).